- Intracranial hemorrhage (HP:0002170): Hemorrhage occurring within the skull. Evidence: TAS. Frequency: Very frequent (HP:0040281). (ORPHA:327)
- Gastrointestinal hemorrhage (HP:0002239): Hemorrhage affecting the gastrointestinal tract. Evidence: TAS. Frequency: Very frequent (HP:0040281). (ORPHA:327)
- Menorrhagia (HP:0000132): Prolonged and excessive menses at regular intervals in excess of 80 mL or lasting longer than 7 days. Evidence: TAS. Frequency: Frequent (HP:0040282). (ORPHA:327)
- Gingival bleeding (HP:0000225): Hemorrhage affecting the gingiva. Evidence: TAS. Frequency: Frequent (HP:0040282). (ORPHA:327)
- Epistaxis (HP:0000421): Epistaxis, or nosebleed, refers to a hemorrhage localized in the nose. Evidence: TAS. Frequency: Frequent (HP:0040282). (ORPHA:327)
- Bruising susceptibility (HP:0000978): An ecchymosis (bruise) refers to the skin discoloration caused by the escape of blood into the tissues from ruptured blood vessels. This term refers to an abnormally increased susceptibility to bruising. The corresponding phenotypic abnormality is generally elicited on medical history as a report of frequent ecchymoses or bruising without adequate trauma. Evidence: TAS. Frequency: Frequent (HP:0040282). (ORPHA:327)
- Prolonged bleeding after surgery (HP:0004846): Bleeding that persists longer than the normal time following a surgical procedure. Evidence: TAS. Frequency: Frequent (HP:0040282). (ORPHA:327)
- Joint hemorrhage (HP:0005261): Hemorrhage occurring within a joint. Evidence: TAS. Frequency: Frequent (HP:0040282). (ORPHA:327)
- Prolonged prothrombin time (HP:0008151): Increased time to coagulation in the prothrombin time test, which is a measure of the extrinsic pathway of coagulation. The results of the prothrombin time test are often expressed in terms of the International normalized ratio (INR), which is calculated as a ratio of the patient's prothrombin time (PT) to a control PT standardized for the potency of the thromboplastin reagent developed by the World Health Organization (WHO) using the formula: INR is equal to Patient PT divided by Control PT. Evidence: TAS. Frequency: Frequent (HP:0040282). (ORPHA:327)
- Ovarian cyst (HP:0000138): The presence of one or more cysts of the ovary. Evidence: TAS. Frequency: Occasional (HP:0040283). (ORPHA:327)
- Abnormality of the umbilical cord (HP:0010881): An abnormality of the umbilical cord, which is the cord connecting the developing embryo or fetus to the placenta. Evidence: TAS. Frequency: Occasional (HP:0040283). (ORPHA:327)
- Post-partum hemorrhage (HP:0011891): Significant maternal hemorrhage/blood loss following deilvery of a child. Evidence: TAS. Frequency: Occasional (HP:0040283). (ORPHA:327)
These phenotypes are associated with the disease Congenital factor VII deficiency (ORPHA:327).